Phenotypes associated with the disease Lupus erythematosus tumidus (ORPHA:90283):
- Cutaneous photosensitivity (HP:0000992): An increased sensitivity of the skin to light. Photosensitivity may result in a rash upon exposure to the sun (which is known as photodermatosis). Photosensitivity can be diagnosed by phototests in which light is shone on small areas of skin. Evidence: TAS. Frequency: Very frequent (HP:0040281). (ORPHA:90283)
- Erythematous plaque (HP:0025474): A plaque (a solid, raised, plateau-like (flat-topped) lesion greater than 1 cm in diameter) with a red or reddish color often associated with inflammation or irritation. Evidence: TAS. Frequency: Very frequent (HP:0040281). (ORPHA:90283)
- Deep dermal perivascular inflammatory infiltrate (HP:0031191): Numerous lymphocytes surrounding blood vessels in the deep part of the dermis. Evidence: TAS. Frequency: Very frequent (HP:0040281). (ORPHA:90283)
- Antinuclear antibody positivity (HP:0003493): The presence of autoantibodies in the serum that react against nuclei or nuclear components. Evidence: TAS. Frequency: Occasional (HP:0040283). (ORPHA:90283)
- Annular cutaneous lesion (HP:0025528): A lesion of the skin with a ring-like distribution. Evidence: TAS. Frequency: Occasional (HP:0040283). (ORPHA:90283)
- Autoimmune antibody positivity (HP:0030057): The presence of an antibody in the blood circulation that is directed against the organism's own cells or tissues. Evidence: TAS. Frequency: Occasional (HP:0040283). (ORPHA:90283)
- Urticarial plaque (HP:0030351): A well-circumscribed, intensely pruritic, raised wheal (edema of the superficial skin) typically 1 to 2 cm in diameter. Evidence: TAS. Frequency: Occasional (HP:0040283). (ORPHA:90283)
- Anti-La/SS-B antibody positivity (HP:0032235): The presence of autoantibodies in the blood circulation that react against La/SSB autoantigens. Evidence: TAS. Frequency: Occasional (HP:0040283). (ORPHA:90283)
- Anti-dsDNA antibody positivity (HP:0020151): The presence of autoantibodies (immunoglobulins) in the serum that react against double-stranded DNA. Evidence: TAS. Frequency: Very rare (HP:0040284). (ORPHA:90283)
Not associated with this disease:
- Depigmentation/hyperpigmentation of skin (HP:0007483). Evidence: TAS. (ORPHA:90283)
- Scaling skin (HP:0040189): Refers to the loss of the outer layer of the epidermis in large, scale-like flakes. Evidence: TAS. (ORPHA:90283)
- Scarring (HP:0100699): A scar refers to a lesion in which wound, burn, or sore has not healed completely and fibrous connective tissue has developed. Evidence: TAS. (ORPHA:90283)